- Intellectual disability (HP:0001249): The term intellectual disability or intellectual developmental disorder is used to describe significantly sub-average intellectual and adaptive functioning based on clinical assessment and as measured by individually administered, appropriately normed, standardized and validated tests of intellectual functioning and adaptive behavior, with onset during the developmental period from infancy through adolescence. Evidence: TAS. Frequency: Very frequent (HP:0040281). (ORPHA:33573)
- Elevated circulating glutathione concentration (HP:0034456): An abnormally increased level of glutathione in the blood circulation. Evidence: TAS. Frequency: Very frequent (HP:0040281). (ORPHA:33573)
- Glutathionuria (HP:0034586): Level of glutathione in the urine above the upper limit of normal. Evidence: TAS. Frequency: Very frequent (HP:0040281). (ORPHA:33573)
- Reduced tissue gamma-glutamyltransferase activity (HP:6000578): Activity of gamma-glutamyltransferase in the tissues below the lower limit of normal. The activity can be measured in multiple tissues including leukocytes and cultured fibroblasts. Evidence: TAS. Frequency: Very frequent (HP:0040281). (ORPHA:33573)
- Strabismus (HP:0000486): A misalignment of the eyes so that the visual axes deviate from bifoveal fixation. The classification of strabismus may be based on a number of features including the relative position of the eyes, whether the deviation is latent or manifest, intermittent or constant, concomitant or otherwise and according to the age of onset and the relevance of any associated refractive error. Evidence: TAS. Frequency: Occasional (HP:0040283). (ORPHA:33573)
- Seizure (HP:0001250): A seizure is an intermittent abnormality of nervous system physiology characterized by a transient occurrence of signs and/or symptoms due to abnormal excessive or synchronous neuronal activity in the brain. Evidence: TAS. Frequency: Occasional (HP:0040283). (ORPHA:33573)
- Ataxia (HP:0001251): Ataxia refers to impaired coordination of voluntary muscle movement. Cerebellar ataxia refers to ataxia due to dysfunction of the cerebellum. This causes a variety of elementary neurological deficits including asynergy (lack of coordination between muscles, limbs and joints), dysmetria (lack of ability to judge distances that can lead to under- or overshoot in grasping movements), and dysdiadochokinesia (inability to perform rapid movements requiring antagonizing muscle groups to be switched on and off repeatedly). Evidence: TAS. Frequency: Occasional (HP:0040283). (ORPHA:33573)
- Tremor (HP:0001337): An unintentional, oscillating to-and-fro muscle movement about a joint axis. Evidence: TAS. Frequency: Occasional (HP:0040283). (ORPHA:33573)
- Hyperreflexia (HP:0001347): Hyperreflexia is the presence of hyperactive stretch reflexes of the muscles. Evidence: TAS. Frequency: Occasional (HP:0040283). (ORPHA:33573)
- Feeding difficulties (HP:0011968): Impaired ability to eat related to problems gathering food and getting ready to suck, chew, or swallow it. Evidence: TAS. Frequency: Occasional (HP:0040283). (ORPHA:33573)
These phenotypes are associated with the disease Gamma-glutamyl transpeptidase deficiency (ORPHA:33573).